- Sensory neuropathy (HP:0000763): Peripheral neuropathy affecting the sensory nerves. Evidence: TAS. Frequency: Very frequent (HP:0040281). (ORPHA:101075)
- Areflexia (HP:0001284): Absence of neurologic reflexes such as the knee-jerk reaction. Evidence: TAS. Frequency: Very frequent (HP:0040281). (ORPHA:101075)
- Pes cavus (HP:0001761): An increase in height of the medial longitudinal arch of the foot that does not flatten on weight bearing (i.e., a distinctly hollow form of the sole of the foot when it is bearing weight). Evidence: TAS. Frequency: Very frequent (HP:0040281). (ORPHA:101075)
- Distal upper limb amyotrophy (HP:0007149): Muscular atrophy of distal arm muscles. Evidence: TAS. Frequency: Very frequent (HP:0040281). (ORPHA:101075)
- Distal lower limb amyotrophy (HP:0008944): Muscular atrophy of distal leg muscles. Evidence: TAS. Frequency: Very frequent (HP:0040281). (ORPHA:101075)
- Abnormal nerve conduction velocity (HP:0040129). Evidence: TAS. Frequency: Very frequent (HP:0040281). (ORPHA:101075)
- Impaired pain sensation (HP:0007328): Reduced ability to perceive painful stimuli. Evidence: TAS. Frequency: Frequent (HP:0040282). (ORPHA:101075)
- Hearing impairment (HP:0000365): A decreased magnitude of the sensory perception of sound. Evidence: TAS. Frequency: Occasional (HP:0040283). (ORPHA:101075)
- Ataxia (HP:0001251): Ataxia refers to impaired coordination of voluntary muscle movement. Cerebellar ataxia refers to ataxia due to dysfunction of the cerebellum. This causes a variety of elementary neurological deficits including asynergy (lack of coordination between muscles, limbs and joints), dysmetria (lack of ability to judge distances that can lead to under- or overshoot in grasping movements), and dysdiadochokinesia (inability to perform rapid movements requiring antagonizing muscle groups to be switched on and off repeatedly). Evidence: TAS. Frequency: Occasional (HP:0040283). (ORPHA:101075)
- Dysarthria (HP:0001260): Dysarthric speech is a general description referring to a neurological speech disorder characterized by poor articulation. Depending on the involved neurological structures, dysarthria may be further classified as spastic, flaccid, ataxic, hyperkinetic and hypokinetic, or mixed. Evidence: TAS. Frequency: Occasional (HP:0040283). (ORPHA:101075)
- Excessive daytime somnolence (HP:0001262): A state of abnormally strong desire for sleep during the daytime. Evidence: TAS. Frequency: Occasional (HP:0040283). (ORPHA:101075)
- Gait disturbance (HP:0001288): The term gait disturbance can refer to any disruption of the ability to walk. Evidence: TAS. Frequency: Occasional (HP:0040283). (ORPHA:101075)
- Tremor (HP:0001337): An unintentional, oscillating to-and-fro muscle movement about a joint axis. Evidence: TAS. Frequency: Occasional (HP:0040283). (ORPHA:101075)
- Language impairment (HP:0002463): Language impairment is a deficit in comprehension or production of language that includes reduced vocabulary, limited sentence structure, or impairments in written or spoken communication. Language abilities are substantially and quantifiably below age expectations. Evidence: TAS. Frequency: Occasional (HP:0040283). (ORPHA:101075)
- Scoliosis (HP:0002650): The presence of an abnormal lateral curvature of the spine. Evidence: TAS. Frequency: Occasional (HP:0040283). (ORPHA:101075)
- Kyphosis (HP:0002808): Exaggerated anterior convexity of the thoracic vertebral column. Evidence: TAS. Frequency: Occasional (HP:0040283). (ORPHA:101075)
These phenotypes are associated with the disease X-linked Charcot-Marie-Tooth disease type 1 (ORPHA:101075).